- Blindness (HP:0000618): Blindness is the condition of lacking visual perception defined as a profound reduction in visual perception. On the 6m visual acuity scale, blindness is defined as less than 3/60. On the 20ft visual acuity scale, blindness is defined as less than 20/400. On the decimal visual acuity scale, blindness is defined as less than 0.05. Blindness is typically characterized by a visual field of no greater than 10 degrees in radius around central fixation. Evidence: TAS. Frequency: Very frequent (HP:0040281). (ORPHA:85336)
- Seizure (HP:0001250): A seizure is an intermittent abnormality of nervous system physiology characterized by a transient occurrence of signs and/or symptoms due to abnormal excessive or synchronous neuronal activity in the brain. Evidence: TAS. Frequency: Very frequent (HP:0040281). (ORPHA:85336)
- Spasticity (HP:0001257): A motor disorder characterized by a velocity-dependent increase in tonic stretch reflexes with increased muscle tone, exaggerated (hyperexcitable) tendon reflexes. Evidence: TAS. Frequency: Very frequent (HP:0040281). (ORPHA:85336)
- Global developmental delay (HP:0001263): A delay in the achievement of motor or mental milestones in the domains of development of a child, including motor skills, speech and language, cognitive skills, and social and emotional skills. This term should only be used to describe children younger than five years of age. Evidence: TAS. Frequency: Very frequent (HP:0040281). (ORPHA:85336)
- Death in infancy (HP:0001522): Death within the first 24 months of life. Evidence: TAS. Frequency: Very frequent (HP:0040281). (ORPHA:85336)
- Severe intellectual disability (HP:0010864): Severe intellectual disability (ID) is defined as a type of ID characterized by severely sub-average adaptive functioning and intellectual functioning, with an intelligence quotient (IQ) the range of 20-34. Evidence: TAS. Frequency: Very frequent (HP:0040281). (ORPHA:85336)
These phenotypes are associated with the disease X-linked neurodegenerative syndrome, Hamel type (ORPHA:85336).